- Delayed epiphyseal ossification (HP:0002663). Evidence: IEA. (OMIM:241530)
- Tibial bowing (HP:0002982): A bending or abnormal curvature of the tibia. Evidence: TAS. (OMIM:241530)
- Difficulty standing (HP:0003698). Evidence: IEA. (OMIM:241530)
- Bulging epiphyses (HP:0003013): A morphological abnormality of epiphyses whereby they are abnormally outwardly curving (protuberant). Evidence: IEA. (OMIM:241530)
- Femoral bowing (HP:0002980): Bowing (abnormal curvature) of the femur. Evidence: TAS. (OMIM:241530)
- Elevated circulating alkaline phosphatase concentration (HP:0003155): Abnormally increased serum levels of alkaline phosphatase activity. Evidence: PCS. Frequency: 7/7. (PMID:16358215)
- Abnormal circulating calcium concentration (HP:0004363): Any deviation from the normal concentration of calcium in the blood circulation. Evidence: PCS. Frequency: 0/5. (PMID:16358215)
- Hypotonia (HP:0001252): Hypotonia is an abnormally low muscle tone (the amount of tension or resistance to movement in a muscle). Even when relaxed, muscles have a continuous and passive partial contraction which provides some resistance to passive stretching. Hypotonia thus manifests as diminished resistance to passive stretching. Hypotonia is not the same as muscle weakness, although the two conditions can co-exist. Evidence: IEA. (OMIM:241530)
- Infantile onset (HP:0003593): Onset of signs or symptoms of disease between 28 days to one year of life. Evidence: IEA. (OMIM:241530)
- Fibular bowing (HP:0010502): A bending or abnormal curvature of the fibula. Evidence: TAS. (OMIM:241530)
- Failure to thrive (HP:0001508): Failure to thrive (FTT) refers to a child whose physical growth is substantially below the norm. Evidence: IEA. (OMIM:241530)
- Bowing of the legs (HP:0002979): A bending or abnormal curvature affecting a long bone of the leg. Evidence: IEA. (OMIM:241530)
- Renal phosphate wasting (HP:0000117): High urine phosphate in the presence of hypophosphatemia. Evidence: PCS. Frequency: 4/4. (PMID:16358215)
- Recurrent fractures (HP:0002757): The repeated occurrence of bone fractures (implying an abnormally increased tendency for fracture). Evidence: IEA. (OMIM:241530)
- Hypophosphatemic rickets (HP:0004912). Evidence: PCS. Frequency: 7/7. (PMID:16358215)
- Muscle weakness (HP:0001324): Reduced strength of muscles. Evidence: IEA. (OMIM:241530)
- Thin bony cortex (HP:0002753): Abnormal thinning of the cortical region of bones. Evidence: IEA. (OMIM:241530)
- Enlargement of the ankles (HP:0003029). Evidence: IEA. (OMIM:241530)
- Flat occiput (HP:0005469): Reduced convexity of the occiput (posterior part of skull). Evidence: IEA. (OMIM:241530)
- Bone pain (HP:0002653): An unpleasant sensation characterized by physical discomfort (such as pricking, throbbing, or aching) localized to bone. Evidence: IEA. (OMIM:241530)
- Sparse bone trabeculae (HP:0002752). Evidence: IEA. (OMIM:241530)
- Bulging of the costochondral junction (HP:0000893): Abnormal outward curving (protuberance) of the junction of ribs and costal cartilage. Evidence: IEA. (OMIM:241530)
- Gait disturbance (HP:0001288): The term gait disturbance can refer to any disruption of the ability to walk. Evidence: IEA. (OMIM:241530)
- Metaphyseal irregularity (HP:0003025): Irregularity of the normally smooth surface of the metaphyses. Evidence: IEA. (OMIM:241530)
- Decreased circulating parathyroid hormone level (HP:0031817): An abnormally decreased concentration of parathyroid hormone. Evidence: PCS. Frequency: 3/4. (PMID:16358215)
- Enlargement of the wrists (HP:0003020). Evidence: IEA. (OMIM:241530)
- Hypercalciuria (HP:0002150). Evidence: PCS. Frequency: 5/5. (PMID:16358215)
- Widely patent fontanelles and sutures (HP:0004492): An abnormally increased width of the cranial fontanelles and sutures. Evidence: IEA. (OMIM:241530)
- Elevated circulating calcifediol concentration (HP:0031414): The concentration of calcifediol in the blood concentration is above the upper limit of normal. Evidence: PCS. Frequency: 0/5. (PMID:16358215)
- Elevated circulating calcitriol concentration (HP:0031415): The concentration of calcitriol in the blood circulation is above the upper limit of normal. Evidence: PCS. Frequency: 4/5. (PMID:16358215)
- Rickets (HP:0002748): Rickets is divided into two major categories including calcipenic and phosphopenic. Hypophosphatemia is described as a common manifestation of both categories. Hypophosphatemic rickets is the most common type of rickets that is characterized by low levels of serum phosphate, resistance to ultraviolet radiation or vitamin D intake. There are several issues involved in hypophosphatemic rickets such as calcium, vitamin D, phosphorus deficiencies. Moreover, other disorder can be associated with its occurrence such as absorption defects due to pancreatic, intestinal, gastric, and renal disorders and hepatobiliary disease. Symptoms are usually seen in childhood and can be varied in severity. Severe forms may be linked to bowing of the legs, poor bone growth, and short stature as well as joint and bone pain. Hypophosphatemic rickets are associated with renal excretion of phosphate, hypophosphatemia, and mineral defects in bones. The familial type of the disease is the most common type of rickets. Evidence: IEA. (OMIM:241530)
- Autosomal recessive inheritance (HP:0000007): A mode of inheritance that is observed for traits related to a gene encoded on one of the autosomes (i.e., the human chromosomes 1-22) in which a trait manifests in individuals with two pathogenic alleles, either homozygotes (two copies of the same mutant allele) or compound heterozygotes (whereby each copy of a gene has a distinct mutant allele). Evidence: PCS. (PMID:16358215)
- Enlargement of the costochondral junction (HP:0000920): Abnormally increased size of the costochondral junctions, which are located between the distal part of the ribs and the costal cartilages, which are bars of hyaline cartilage that connect the ribs to the sternum. Evidence: IEA. (OMIM:241530)
- Frontal bossing (HP:0002007): Bilateral bulging of the lateral frontal bone prominences with relative sparing of the midline. Evidence: IEA. (OMIM:241530)
- Calcium nephrolithiasis (HP:0004724): The presence of calcium-containing calculi (stones) in the kidneys. Evidence: IEA. (OMIM:241530)
- Growth delay (HP:0001510): A deficiency or slowing down of growth pre- and postnatally. Evidence: TAS. (OMIM:241530)
- Renal tubular dysfunction (HP:0000124): Abnormal function of the renal tubule. The basic functional unit of the kidney, the nephron, consists of a renal corpuscle attached to a renal tubule, with roughly 0.8 to 1.5 nephrons per adult kidney. The functions of the renal tubule include reabsorption of water, electrolytes, glucose, and amino acids and secretion of substances such as uric acid. Evidence: TAS. (OMIM:241530)
- Deformed rib cage (HP:0000886): Malformation of the rib cage. Evidence: IEA. (OMIM:241530)
- Hypophosphatemia (HP:0002148): The concentration of phosphate ion in the blood circulation is below the lower limit of normal. Evidence: PCS. Frequency: 7/7. (PMID:16358215)
These phenotypes are associated with the disease hereditary hypophosphatemic rickets with hypercalciuria (OMIM:241530).